- Anemia (HP:0001903): A reduction in erythrocytes volume or hemoglobin concentration. Evidence: TAS. Frequency: Very frequent (HP:0040281). (ORPHA:508542)
- Bone marrow hypocellularity (HP:0005528): A reduced number of hematopoietic cells present in the bone marrow relative to marrow fat. Evidence: TAS. Frequency: Very frequent (HP:0040281). (ORPHA:508542)
- Coarse facial features (HP:0000280): Absence of fine and sharp appearance of brows, nose, lips, mouth, and chin, usually because of rounded and heavy features or thickened skin with or without thickening of subcutaneous and bony tissues. Evidence: TAS. Frequency: Frequent (HP:0040282). (ORPHA:508542)
- Intellectual disability (HP:0001249): The term intellectual disability or intellectual developmental disorder is used to describe significantly sub-average intellectual and adaptive functioning based on clinical assessment and as measured by individually administered, appropriately normed, standardized and validated tests of intellectual functioning and adaptive behavior, with onset during the developmental period from infancy through adolescence. Evidence: TAS. Frequency: Frequent (HP:0040282). (ORPHA:508542)
- Congestive heart failure (HP:0001635): The presence of an abnormality of cardiac function that is responsible for the failure of the heart to pump blood at a rate that is commensurate with the needs of the tissues or a state in which abnormally elevated filling pressures are required for the heart to do so. Heart failure is frequently related to a defect in myocardial contraction. Evidence: TAS. Frequency: Frequent (HP:0040282). (ORPHA:508542)
- Thrombocytopenia (HP:0001873): A reduction in the number of circulating thrombocytes. Evidence: TAS. Frequency: Frequent (HP:0040282). (ORPHA:508542)
- Decreased total neutrophil count (HP:0001875): Abnormal decrease of absolute number of neutrophils in the blood, per microlitre, compared to a reference range for a given sex and age-group. Evidence: TAS. Frequency: Frequent (HP:0040282). (ORPHA:508542)
- Decreased total leukocyte count (HP:0001882): An abnormal decreased number of leukocytes in the blood. Evidence: TAS. Frequency: Frequent (HP:0040282). (ORPHA:508542)
- Decreased total lymphocyte count (HP:0001888): A reduced number of lymphocytes in the blood. Evidence: TAS. Frequency: Frequent (HP:0040282). (ORPHA:508542)
- Reticulocytopenia (HP:0001896): A reduced number of reticulocytes in the peripheral blood. Evidence: TAS. Frequency: Frequent (HP:0040282). (ORPHA:508542)
- Abnormal facial shape (HP:0001999): An abnormal morphology (form) of the face or its components. Evidence: TAS. Frequency: Frequent (HP:0040282). (ORPHA:508542)
- Recurrent upper respiratory tract infections (HP:0002788): An increased susceptibility to upper respiratory tract infections as manifested by a history of recurrent upper respiratory tract infections (running ears - otitis, sinusitis, pharyngitis, tonsillitis). Evidence: TAS. Frequency: Frequent (HP:0040282). (ORPHA:508542)
- Myelodysplasia (HP:0002863): Clonal hematopoietic stem cell disorders characterized by dysplasia (ineffective production) in one or more hematopoietic cell lineages, leading to anemia and cytopenia. Evidence: TAS. Frequency: Frequent (HP:0040282). (ORPHA:508542)
- Short stature (HP:0004322): A height below that which is expected according to age and gender norms. Although there is no universally accepted definition of short stature, many refer to "short stature" as height more than 2 standard deviations below the mean for age and gender (or below the 3rd percentile for age and gender dependent norms). Evidence: TAS. Frequency: Frequent (HP:0040282). (ORPHA:508542)
- Cerebral hypoplasia (HP:0006872): Underdevelopment of the cerebrum. Evidence: TAS. Frequency: Frequent (HP:0040282). (ORPHA:508542)
- Decreased total B cell count (HP:0010976): The absolute number of B cells in the blood, per microlitre is below the lower limit of normal of the reference range for the appropriate sex and age-group. Evidence: TAS. Frequency: Frequent (HP:0040282). (ORPHA:508542)
- Neurodevelopmental delay (HP:0012758): Neurodevelopmental delay (NDD) refers to delays in the maturation of the brain and central nervous system; infants and young children with NDD may experience delays in the development of one or more skills including gross motor abilities, fine-motor coordination, language abilities and ability to solve increasingly complex problems. Evidence: TAS. Frequency: Frequent (HP:0040282). (ORPHA:508542)
- Erythroid dysplasia (HP:0031688): Dysplasia in the erythroid lineage, which presents with a variety of morphological changes in the bone marrow, including nuclear budding or irregular nuclear contour in erythroblasts. Evidence: TAS. Frequency: Frequent (HP:0040282). (ORPHA:508542)
- Megakaryocyte dysplasia (HP:0031689): The presence of micro-megakaryocytes, hypo-lobed, or non-lobed nuclei in megakaryocytes of all sizes and multiple, widely-separated nuclei. Evidence: TAS. Frequency: Frequent (HP:0040282). (ORPHA:508542)
- Gingival overgrowth (HP:0000212): Hyperplasia of the gingiva (that is, a thickening of the soft tissue overlying the alveolar ridge. The degree of thickening ranges from involvement of the interdental papillae alone to gingival overgrowth covering the entire tooth crown. Evidence: TAS. Frequency: Occasional (HP:0040283). (ORPHA:508542)
- Trigonocephaly (HP:0000243): Wedge-shaped, or triangular head, with the apex of the triangle at the midline of the forehead and the base of the triangle at the occiput. Evidence: TAS. Frequency: Occasional (HP:0040283). (ORPHA:508542)
- Hearing impairment (HP:0000365): A decreased magnitude of the sensory perception of sound. Evidence: TAS. Frequency: Occasional (HP:0040283). (ORPHA:508542)
- Cataract (HP:0000518): A cataract is an opacity or clouding that develops in the crystalline lens of the eye or in its capsule. Evidence: TAS. Frequency: Occasional (HP:0040283). (ORPHA:508542)
- Delayed eruption of teeth (HP:0000684): Delayed tooth eruption, which can be defined as tooth eruption more than 2 SD beyond the mean eruption age. Evidence: TAS. Frequency: Occasional (HP:0040283). (ORPHA:508542)
- Abnormal thorax morphology (HP:0000765): Any abnormality of the thorax (the region of the body formed by the sternum, the thoracic vertebrae and the ribs). Evidence: TAS. Frequency: Occasional (HP:0040283). (ORPHA:508542)
- Broad clavicle (HP:0000916): Increased width (cross-sectional diameter) of the clavicles. Evidence: TAS. Frequency: Occasional (HP:0040283). (ORPHA:508542)
- Dry skin (HP:0000958): Skin characterized by the lack of natural or normal moisture. Evidence: TAS. Frequency: Occasional (HP:0040283). (ORPHA:508542)
- Eczematoid dermatitis (HP:0000964): Eczema is a form of dermatitis that is characterized by scaly, pruritic, erythematous lesions located on flexural surfaces. Evidence: TAS. Frequency: Occasional (HP:0040283). (ORPHA:508542)
- Brachydactyly (HP:0001156): Digits that appear disproportionately short compared to the hand/foot. The word brachydactyly is used here to describe a series distinct patterns of shortened digits (brachydactyly types A-E). This is the sense used here. Evidence: TAS. Frequency: Occasional (HP:0040283). (ORPHA:508542)
- Subcutaneous nodule (HP:0001482): Slightly elevated lesions on or in the skin with a diameter of over 5 mm. Evidence: TAS. Frequency: Occasional (HP:0040283). (ORPHA:508542)
- Recurrent lower respiratory tract infections (HP:0002783): An increased susceptibility to lower respiratory tract infections as manifested by a history of recurrent lower respiratory tract infections. Evidence: TAS. Frequency: Occasional (HP:0040283). (ORPHA:508542)
- Rhizomelic arm shortening (HP:0004991): Disproportionate shortening of the proximal segment of the arm (i.e. the humerus). Evidence: TAS. Frequency: Occasional (HP:0040283). (ORPHA:508542)
- Tricuspid regurgitation (HP:0005180): Failure of the tricuspid valve to close sufficiently upon contraction of the right ventricle, causing blood to regurgitate (flow backward) into the right atrium. Evidence: TAS. Frequency: Occasional (HP:0040283). (ORPHA:508542)
- Short humerus (HP:0005792): Underdevelopment of the humerus. Evidence: TAS. Frequency: Occasional (HP:0040283). (ORPHA:508542)
- Short metacarpal (HP:0010049): Diminished length of one or more metacarpal bones in relation to the others of the same hand or to the contralateral metacarpal. Evidence: TAS. Frequency: Occasional (HP:0040283). (ORPHA:508542)
- Midface retrusion (HP:0011800): Posterior positions and/or vertical shortening of the infraorbital and perialar regions, or increased concavity of the face and/or reduced nasolabial angle. Evidence: TAS. Frequency: Occasional (HP:0040283). (ORPHA:508542)
- Panniculitis (HP:0012490): Inflammation of subcutaneous adipose tissue. Evidence: TAS. Frequency: Occasional (HP:0040283). (ORPHA:508542)
- Noncompaction cardiomyopathy (HP:0012817): A type of cardiomyopathy characterized anatomically by deep trabeculations in the ventricular wall, which define recesses communicating with the main ventricular chamber. Evidence: TAS. Frequency: Occasional (HP:0040283). (ORPHA:508542)
These phenotypes are associated with the disease Congenital progressive bone marrow failure-B-cell immunodeficiency-skeletal dysplasia syndrome (ORPHA:508542).